- Dry skin (HP:0000958): Skin characterized by the lack of natural or normal moisture. Evidence: TAS. Frequency: Very frequent (HP:0040281). (ORPHA:94059)
- Pruritus (HP:0000989): Pruritus is an itch or a sensation that makes a person want to scratch. This term refers to an abnormally increased disposition to experience pruritus. Evidence: TAS. Frequency: Very frequent (HP:0040281). (ORPHA:94059)
- Increased blood urea nitrogen (HP:0003138): An increased amount of nitrogen in the form of urea in the blood. Evidence: TAS. Frequency: Very frequent (HP:0040281). (ORPHA:94059)
- Chronic kidney disease (HP:0012622): Functional anomaly of the kidney persisting for at least three months. Evidence: TAS. Frequency: Very frequent (HP:0040281). (ORPHA:94059)
- Sleep disturbance (HP:0002360): An abnormal pattern in the quality, quantity, or characteristics of sleep. Evidence: TAS. Frequency: Frequent (HP:0040282). (ORPHA:94059)
- Stage 5 chronic kidney disease (HP:0003774): A degree of kidney failure severe enough to require dialysis or kidney transplantation for survival characterized by a severe reduction in glomerular filtration rate (less than 15 ml/min/1.73 m2) and other manifestations including increased serum creatinine. Evidence: TAS. Frequency: Frequent (HP:0040282). (ORPHA:94059)
- Abnormal circulating cytokine concentration (HP:0011112): Abnormality of the cytokine levels in the blood, i.e., an abnormality of any of the non-antibody proteins made by inflammatory leukocytes and some non-leukocytic cells that affect the behavior of other cells. Evidence: TAS. Frequency: Frequent (HP:0040282). (ORPHA:94059)
- Generalized abnormality of skin (HP:0011354): An abnormality of the skin that is not localized to any one particular region. Evidence: TAS. Frequency: Frequent (HP:0040282). (ORPHA:94059)
- Maintenance insomnia (HP:0031355): Individuals affected by abnormal difficulty in staying asleep tend to wake up at night and struggle to return to sleep. This condition typically involves spending more than 30 minutes awake during the night. Evidence: TAS. Frequency: Frequent (HP:0040282). (ORPHA:94059)
- Elevated total serum tryptase (HP:0031901): An abnormally elevated concentration of total tryptase (alpha and beta tryptase) in the blood circulation. Evidence: TAS. Frequency: Frequent (HP:0040282). (ORPHA:94059)
- Depression (HP:0000716): Frequently experiencing feelings of being down, miserable, and/or hopeless; struggling to recover from these moods; having a pessimistic outlook on the future; feeling a pervasive sense of shame; having a low self-worth; experiencing thoughts of suicide and engaging in suicidal behavior. Evidence: TAS. Frequency: Occasional (HP:0040283). (ORPHA:94059)
- Recurrent skin infections (HP:0001581): Infections of the skin that happen multiple times. Evidence: TAS. Frequency: Occasional (HP:0040283). (ORPHA:94059)
- Hypermagnesemia (HP:0002918): The concentration of magnesium in the blood circulation is above the upper limit of normal. Evidence: TAS. Frequency: Occasional (HP:0040283). (ORPHA:94059)
- Hypercalcemia (HP:0003072): The concentration of calcium in the blood circulation is above the upper limit of normal. Evidence: TAS. Frequency: Occasional (HP:0040283). (ORPHA:94059)
- Renal hypophosphatemia (HP:0008732): Renal hypophosphatemia is defined as reduced serum phosphate (e.g., below 0.70 mmol/l) and an inappropriately high renal phosphate excretion. Evidence: TAS. Frequency: Occasional (HP:0040283). (ORPHA:94059)
- Inflammatory abnormality of the skin (HP:0011123): The presence of inflammation of the skin. That is, an abnormality of the skin resulting from the local accumulation of fluid, plasma proteins, and leukocytes. Evidence: TAS. Frequency: Occasional (HP:0040283). (ORPHA:94059)
- Lichenification (HP:0100725): Thickening and hardening of the epidermis seen with exaggeration of normal skin lines. Evidence: TAS. Frequency: Occasional (HP:0040283). (ORPHA:94059)
- Papule (HP:0200034): A circumscribed, solid elevation of skin with no visible fluid, varying in size from a pinhead to less than 10mm in diameter at the widest point. Evidence: TAS. Frequency: Occasional (HP:0040283). (ORPHA:94059)
These phenotypes are associated with the disease Uremic pruritus (ORPHA:94059).